Phenotypes associated with the disease Acute generalized exanthematous pustulosis (ORPHA:293173):
- Increased total leukocyte count (HP:0001974): An abnormal increase in the number of leukocytes in the blood. Evidence: TAS. Frequency: Very frequent (HP:0040281). (ORPHA:293173)
- Pustule (HP:0200039): A small elevation of the skin containing cloudy or purulent material usually consisting of necrotic inflammatory cells. Evidence: TAS. Frequency: Very frequent (HP:0040281). (ORPHA:293173)
- Pruritus (HP:0000989): Pruritus is an itch or a sensation that makes a person want to scratch. This term refers to an abnormally increased disposition to experience pruritus. Evidence: TAS. Frequency: Frequent (HP:0040282). (ORPHA:293173)
- Increased total eosinophil count (HP:0001880): Increased count of eosinophils in the blood. Evidence: TAS. Frequency: Frequent (HP:0040282). (ORPHA:293173)
- Fever (HP:0001945): Body temperature elevated above the normal range. Evidence: TAS. Frequency: Frequent (HP:0040282). (ORPHA:293173)
- Elevated erythrocyte sedimentation rate (HP:0003565): An increased erythrocyte sedimentation rate (ESR). The ESR is a test that measures the distance that erythrocytes have fallen after one hour in a vertical column of anticoagulated blood under the influence of gravity. The ESR is a nonspecific finding. An elevation may indicate inflammation or may be caused by any condition that elevates fibrinogen. Evidence: TAS. Frequency: Frequent (HP:0040282). (ORPHA:293173)
- Increased total neutrophil count (HP:0011897): Abnormal increase of absolute number of neutrophils in the blood, per microliter, compared to a reference range for a given sex and age-group. Evidence: TAS. Frequency: Frequent (HP:0040282). (ORPHA:293173)
- Eosinophilic dermal infiltration (HP:0032022): Presence of abnormally increased amounts of intraepidermal inflammatory cells with a predominance of eosinophils. Evidence: TAS. Frequency: Frequent (HP:0040282). (ORPHA:293173)
- Scaling skin (HP:0040189): Refers to the loss of the outer layer of the epidermis in large, scale-like flakes. Evidence: TAS. Frequency: Frequent (HP:0040282). (ORPHA:293173)
- Renal insufficiency (HP:0000083): A reduction in the level of performance of the kidneys in areas of function comprising the concentration of urine, removal of wastes, the maintenance of electrolyte balance, homeostasis of blood pressure, and calcium metabolism. Evidence: TAS. Frequency: Occasional (HP:0040283). (ORPHA:293173)
- Facial edema (HP:0000282). Evidence: TAS. Frequency: Occasional (HP:0040283). (ORPHA:293173)
- Purpura (HP:0000979): Purpura (from Latin: purpura, meaning purple) is the appearance of red or purple discolorations on the skin that do not blanch on applying pressure. They are caused by bleeding underneath the skin. This term refers to an abnormally increased susceptibility to developing purpura. Purpura are larger than petechiae. Evidence: TAS. Frequency: Occasional (HP:0040283). (ORPHA:293173)
- Cholestasis (HP:0001396): Impairment of bile flow due to obstruction in bile ducts. Evidence: TAS. Frequency: Occasional (HP:0040283). (ORPHA:293173)
- Dyspnea (HP:0002094): Difficult or labored breathing. Dyspnea is a subjective feeling only the patient can rate, e.g., on a Borg scale. Evidence: TAS. Frequency: Occasional (HP:0040283). (ORPHA:293173)
- Elevated circulating hepatic transaminase concentration (HP:0002910): Elevations of the levels of SGOT and SGPT in the serum. SGOT (serum glutamic oxaloacetic transaminase) and SGPT (serum glutamic pyruvic transaminase) are transaminases primarily found in the liver and heart and are released into the bloodstream as the result of liver or heart damage. SGOT and SGPT are used clinically mainly as markers of liver damage. Evidence: TAS. Frequency: Occasional (HP:0040283). (ORPHA:293173)
- Predominantly dermal neutrophilic infiltrate (HP:0031236): Collection of neutrophils in the dermis. Evidence: TAS. Frequency: Occasional (HP:0040283). (ORPHA:293173)
- Acantholysis (HP:0100792): The loss of intercellular connections, such as desmosomes, resulting in loss of cohesion between keratinocytes. Evidence: TAS. Frequency: Occasional (HP:0040283). (ORPHA:293173)
- Cheilitis (HP:0100825): Inflammation of the lip. Evidence: TAS. Frequency: Occasional (HP:0040283). (ORPHA:293173)
- Skin vesicle (HP:0200037): A circumscribed, fluid-containing, epidermal elevation less than 10mm in diameter at the widest point that (i) Contain serous exudates or serum mixed with blood or pus; (ii) Are discrete, grouped, irregularly distributed, or linear as in Rhus dermatitis; (iii) Are short-lived. Vesicles may break spontaneously or evolve into bullae by enlarging or coalescing with other vesicles. Evidence: TAS. Frequency: Occasional (HP:0040283). (ORPHA:293173)
- Conjunctivitis (HP:0000509): Inflammation of the conjunctiva. Evidence: TAS. Frequency: Very rare (HP:0040284). (ORPHA:293173)
- Hyperpigmentation of the skin (HP:0000953): A darkening of the skin related to an increase in melanin production and deposition. Evidence: TAS. Frequency: Very rare (HP:0040284). (ORPHA:293173)
- Decreased total neutrophil count (HP:0001875): Abnormal decrease of absolute number of neutrophils in the blood, per microlitre, compared to a reference range for a given sex and age-group. Evidence: TAS. Frequency: Very rare (HP:0040284). (ORPHA:293173)
- Lymphadenopathy (HP:0002716): Enlargement (swelling) of a lymph node. Evidence: TAS. Frequency: Very rare (HP:0040284). (ORPHA:293173)